Phenotypes associated with the disease immunodeficiency 65, susceptibility to viral infections (OMIM:618648):
- Gingivitis (HP:0000230): Inflammation of the gingiva. Evidence: PCS. (PMID:30826365)
- Stomatitis (HP:0010280): Stomatitis is an inflammation of the mucous membranes of any of the structures in the mouth. Evidence: PCS. (PMID:30826365)
- Bronchiectasis (HP:0002110): Persistent abnormal dilatation of the bronchi owing to localized and irreversible destruction and widening of the large airways. Evidence: PCS. (PMID:30826365)
- Autosomal recessive inheritance (HP:0000007): A mode of inheritance that is observed for traits related to a gene encoded on one of the autosomes (i.e., the human chromosomes 1-22) in which a trait manifests in individuals with two pathogenic alleles, either homozygotes (two copies of the same mutant allele) or compound heterozygotes (whereby each copy of a gene has a distinct mutant allele). Evidence: PCS. (PMID:30826365)
- Recurrent gastroenteritis (HP:0031123): Increased susceptibility to gastroenteritis, an infectious inflammationof the stomach and small intestines manifested by signs and symptoms such as diarheas and abdominal pain, as manifested by recurrent episodes of gastroenteritis. Evidence: PCS. (PMID:30826365)
- Recurrent viral infections (HP:0004429): Increased susceptibility to viral infections as manifested by recurrent episodes of viral infection. Evidence: PCS. Onset: Infantile onset (HP:0003593). (PMID:30826365)